- Early young adult onset (HP:0025708): Onset of disease at an age of greater than or equal to 16 to under 19 years. Evidence: PCS. Frequency: 3/3. (PMID:36593121)
- Irregularly shaped sperm tail (HP:0033393): Irregular or changing caliber (diameter) along the tail of the sperm. Evidence: PCS. Frequency: 2/2. (PMID:36593121)
- Low semen volume (HP:6000135): Volume of semen in ejaculate below the lower limit of normal. This finding can be ascertained by semen analysis. Comment: Sperm are produced within the testis, in the process of spermatogenesis, then travel through the male reproductive tract (the seminiferous tubules, epididymis, vas deferens, prostate and urethra). As the sperm travel, seminal fluid is added from the seminal vesicles, prostate, testis and epididymis and periurethral glands. The function of the ejaculate is to transport sperm into the female genital tract and to provide a suitable environment for sperm survival during this transit. Evidence: PCS. Frequency: 1/3. (PMID:36593121)
- Reduced progressive sperm motility (HP:0034011): A reduced proportion of sperm that move in a straight line or large circles; alternatively, an increased proportion of sperm that move in tight circles or in some other non-linear fashion. Evidence: PCS. Frequency: 2/2. (PMID:36593121)
- Coiled sperm flagella (HP:0032560): Sperm cells whose flagella are twisted (coiled). Evidence: PCS. Frequency: 1/2. (PMID:36593121)
- Male infertility (HP:0003251). Evidence: PCS. Frequency: 3/3. (PMID:36593121)
- Reduced sperm motility (HP:0012207): An abnormal reduction in the mobility of ejaculated sperm. Evidence: PCS. Frequency: 2/2. (PMID:36593121)
- Autosomal recessive inheritance (HP:0000007): A mode of inheritance that is observed for traits related to a gene encoded on one of the autosomes (i.e., the human chromosomes 1-22) in which a trait manifests in individuals with two pathogenic alleles, either homozygotes (two copies of the same mutant allele) or compound heterozygotes (whereby each copy of a gene has a distinct mutant allele). Evidence: PCS. (PMID:36593121)
- Bent sperm flagella (HP:0034811): The proportion of sperm cells whose flagella is sharply curved or has a sharp angle is above normal limits. Evidence: PCS. Frequency: 0/2. (PMID:36593121)
- Oligozoospermia (HP:0000798): Reduced count of spermatozoa in the semen, defined as a sperm count below 20 million per milliliter semen. Evidence: PCS. Frequency: 3/3. (PMID:36593121)
- Absent sperm flagella (HP:0032558): Sperm cells lacking flagella. Evidence: PCS. Frequency: 2/2. (PMID:36593121)
- Short sperm flagella (HP:0032559): Sperm cells with abnormally short flagella. Evidence: PCS. Frequency: 2/2. (PMID:36593121)
These phenotypes are associated with the disease spermatogenic failure 98 (OMIM:621124).